- Abnormal foot morphology (HP:0001760): An abnormality of the skeleton of foot. Evidence: PCS. (PMID:13437469)
- Abnormality of the os naviculare pedis (HP:0100339). Evidence: PCS. (PMID:13437469)
- Pes planus (HP:0001763): A foot where the longitudinal arch of the foot is in contact with the ground or floor when the individual is standing; or, in a patient lying supine, a foot where the arch is in contact with the surface of a flat board pressed against the sole of the foot by the examiner with a pressure similar to that expected from weight bearing; or, the height of the arch is reduced. Evidence: PCS. (PMID:10668560)
- Autosomal dominant inheritance (HP:0000006): A mode of inheritance that is observed for traits related to a gene encoded on one of the autosomes (i.e., the human chromosomes 1-22) in which a trait manifests in heterozygotes. In the context of medical genetics, an autosomal dominant disorder is caused when a single copy of the mutant allele is present. Males and females are affected equally, and can both transmit the disorder with a risk of 50% for each child of inheriting the mutant allele. Evidence: IEA. (OMIM:161600)
These phenotypes are associated with the disease Accessory navicular bone (OMIM:161600).